Phenotypes associated with the disease scoliosis, isolated, susceptibility to, 1 (OMIM:181800):
- Scoliosis (HP:0002650): The presence of an abnormal lateral curvature of the spine. Evidence: IEA. (OMIM:181800)
- Autosomal dominant inheritance (HP:0000006): A mode of inheritance that is observed for traits related to a gene encoded on one of the autosomes (i.e., the human chromosomes 1-22) in which a trait manifests in heterozygotes. In the context of medical genetics, an autosomal dominant disorder is caused when a single copy of the mutant allele is present. Males and females are affected equally, and can both transmit the disorder with a risk of 50% for each child of inheriting the mutant allele. Evidence: TAS. (OMIM:181800)